Phenotypes associated with the disease ADULT syndrome (ORPHA:978):
- Abnormality of the dentition (HP:0000164): Any abnormality of the teeth. Evidence: TAS. Frequency: Very frequent (HP:0040281). (ORPHA:978)
- Abnormality of the face (HP:0000271): An abnormality of the face. Evidence: TAS. Frequency: Occasional (HP:0040283). (ORPHA:978)
- Prominent nasal bridge (HP:0000426): Anterior positioning of the nasal root in comparison to the usual positioning for age. Evidence: TAS. Frequency: Occasional (HP:0040283). (ORPHA:978)
- Wide nasal bridge (HP:0000431): Increased breadth of the nasal bridge (and with it, the nasal root). Evidence: TAS. Frequency: Occasional (HP:0040283). (ORPHA:978)
- Nasolacrimal duct obstruction (HP:0000579): Blockage of the lacrimal duct. Evidence: TAS. Frequency: Very frequent (HP:0040281). (ORPHA:978)
- Dry skin (HP:0000958): Skin characterized by the lack of natural or normal moisture. Evidence: TAS. Frequency: Very frequent (HP:0040281). (ORPHA:978)
- Thin skin (HP:0000963): Reduction in thickness of the skin, generally associated with a loss of suppleness and elasticity of the skin. Evidence: TAS. Frequency: Very frequent (HP:0040281). (ORPHA:978)
- Melanocytic nevus (HP:0000995): A oval and round, colored (usually medium-to dark brown, reddish brown, or flesh colored) lesion. Typically, a melanocytic nevus is less than 6 mm in diameter, but may be much smaller or larger. Evidence: TAS. Frequency: Very frequent (HP:0040281). (ORPHA:978)
- Freckling (HP:0001480): The presence of an increased number of freckles, small circular spots on the skin that are darker than the surrounding skin because of deposits of melanin. Evidence: TAS. Frequency: Very frequent (HP:0040281). (ORPHA:978)
- Alopecia (HP:0001596): A noncongenital process of hair loss, which may progress to partial or complete baldness. Evidence: TAS. Frequency: Frequent (HP:0040282). (ORPHA:978)
- Abnormal nail morphology (HP:0001597): Abnormal structure or appearance of the nail. Evidence: TAS. Frequency: Very frequent (HP:0040281). (ORPHA:978)
- Toe syndactyly (HP:0001770): Webbing or fusion of the toes, involving soft parts only or including bone structure. Bony fusions are referred to as "bony" Syndactyly if the fusion occurs in a radio-ulnar axis. Fusions of bones of the toes in a proximo-distal axis are referred to as "Symphalangism". Evidence: TAS. Frequency: Very frequent (HP:0040281). (ORPHA:978)
- Nail pits (HP:0001803): Small (typically about 1 mm or less in size) depressions on the dorsal nail surface. Evidence: TAS. Frequency: Very frequent (HP:0040281). (ORPHA:978)
- Split foot (HP:0001839): A condition in which middle parts of the foot (toes and metatarsals) are missing giving a cleft appearance. The severity is very variable ranging from slightly hypoplastic 3rd toe over absent 2nd or 3rd toes as far as oligo- or monodactyl feet. Evidence: TAS. Frequency: Very frequent (HP:0040281). (ORPHA:978)
- Sparse scalp hair (HP:0002209): Decreased number of hairs per unit area of skin of the scalp. Evidence: TAS. Frequency: Frequent (HP:0040282). (ORPHA:978)
- Fine hair (HP:0002213): Hair that is fine or thin to the touch. Evidence: TAS. Frequency: Very frequent (HP:0040281). (ORPHA:978)
- Hypoplastic nipples (HP:0002557): Underdevelopment of the nipple. Evidence: TAS. Frequency: Frequent (HP:0040282). (ORPHA:978)
- Absent nipple (HP:0002561): Congenital failure to develop, and absence of, the nipple. Evidence: TAS. Frequency: Frequent (HP:0040282). (ORPHA:978)
- Breast hypoplasia (HP:0003187): Underdevelopment of the breast. Evidence: TAS. Frequency: Frequent (HP:0040282). (ORPHA:978)
- Finger syndactyly (HP:0006101): Webbing or fusion of the fingers, involving soft parts only or including bone structure. Bony fusions are referred to as "bony" Syndactyly if the fusion occurs in a radio-ulnar axis. Fusions of bones of the fingers in a proximo-distal axis are referred to as "Symphalangism". Evidence: TAS. Frequency: Very frequent (HP:0040281). (ORPHA:978)
- Abnormal dental morphology (HP:0006482): An abnormality of the morphology of the tooth. Evidence: TAS. Frequency: Frequent (HP:0040282). (ORPHA:978)
- Toenail dysplasia (HP:0100797): An abnormality of the development of the toenails. Evidence: TAS. Frequency: Very frequent (HP:0040281). (ORPHA:978)
- Fingernail dysplasia (HP:0100798): An abnormality of the development of the fingernails. Evidence: TAS. Frequency: Very frequent (HP:0040281). (ORPHA:978)
- Skin ulcer (HP:0200042): A discontinuity of the skin exhibiting complete loss of the epidermis and often portions of the dermis and even subcutaneous fat. Evidence: TAS. Frequency: Very frequent (HP:0040281). (ORPHA:978)